Phenotypes associated with the disease Hypertelorism-hypospadias-polysyndactyly syndrome (ORPHA:2211):
- Pachygyria (HP:0001302): Pachygyria is a malformation of cortical development with abnormally wide gyri with sulci 1,5-3 cm apart and abnormally thick cortex measuring more than 5 mm (radiological definition). See also neuropathological definitions for 2-, 3-, and 4-layered lissencephaly. Evidence: TAS. Frequency: Occasional (HP:0040283). (ORPHA:2211)
- Abnormal penis morphology (HP:0000036): Abnormality of the male external sex organ. Evidence: TAS. Frequency: Very frequent (HP:0040281). (ORPHA:2211)
- Epispadias (HP:0000039): Epispadias is a urogenital malformation characterized by the failure of the urethral tube to tubularize on the dorsal aspect. Unlike in hypospadias, where the meatus is on the ventral aspect, children with epispadias have a wide-open urethral plate on the dorsum. It is commonly seen as a component in the spectrum of bladder exstrophy-epispadias-complex. Isolated epispadias constitutes less than 10 percent of the total cases of epispadias. Evidence: TAS. Frequency: Very frequent (HP:0040281). (ORPHA:2211)
- Hypospadias (HP:0000047): Abnormal position of urethral meatus on the ventral penile shaft (underside) characterized by displacement of the urethral meatus from the tip of the glans penis to the ventral surface of the penis, scrotum, or perineum. Evidence: TAS. Frequency: Very frequent (HP:0040281). (ORPHA:2211)
- Shawl scrotum (HP:0000049): Superior margin of the scrotum superior to the base of the penis. Evidence: TAS. Frequency: Very frequent (HP:0040281). (ORPHA:2211)
- Large fontanelles (HP:0000239): In newborns, the two frontal bones, two parietal bones, and one occipital bone are joined by fibrous sutures, which form a small posterior fontanelle, and a larger, diamond-shaped anterior fontanelle. These regions allow for the skull to pass the birth canal and for later growth. The fontanelles gradually ossify, whereby the posterior fontanelle usually closes by eight weeks and the anterior fontanelle by the 9th to 16th month of age. Large fontanelles are diagnosed if the fontanelles are larger than age-dependent norms. Evidence: TAS. Frequency: Very frequent (HP:0040281). (ORPHA:2211)
- Brachycephaly (HP:0000248): An abnormality of skull shape characterized by a decreased anterior-posterior diameter. That is, a cephalic index greater than 81%. Alternatively, an apparently shortened anteroposterior dimension (length) of the head compared to width. Evidence: TAS. Frequency: Very frequent (HP:0040281). (ORPHA:2211)
- Delayed cranial suture closure (HP:0000270): Infants normally have two fontanels at birth, the diamond-shaped anterior fontanelle at the junction of the coronal and sagittal sutures, and the posterior fontanelle at the intersection of the occipital and parietal bones. The posterior fontanelle usually closes by the 8th week of life, and the anterior fontanel closes by the 18th month of life on average. This term applies if there is delay of closure of the fontanelles beyond the normal age. Evidence: TAS. Frequency: Very frequent (HP:0040281). (ORPHA:2211)
- Hypertelorism (HP:0000316): Interpupillary distance more than 2 SD above the mean (alternatively, the appearance of an increased interpupillary distance or widely spaced eyes). Evidence: TAS. Frequency: Very frequent (HP:0040281). (ORPHA:2211)
- Posteriorly rotated ears (HP:0000358): A type of abnormal location of the ears in which the position of the ears is characterized by posterior rotation (the superior part of the ears is rotated towards the back of the head, and the inferior part of the ears towards the front). Evidence: TAS. Frequency: Very frequent (HP:0040281). (ORPHA:2211)
- Low-set ears (HP:0000369): Upper insertion of the ear to the scalp below an imaginary horizontal line drawn between the inner canthi of the eye and extending posteriorly to the ear. Evidence: TAS. Frequency: Very frequent (HP:0040281). (ORPHA:2211)
- Wide nasal bridge (HP:0000431): Increased breadth of the nasal bridge (and with it, the nasal root). Evidence: TAS. Frequency: Very frequent (HP:0040281). (ORPHA:2211)
- Depressed nasal ridge (HP:0000457): Lack of prominence of the nose resulting from a posteriorly-placed nasal ridge. Evidence: TAS. Frequency: Very frequent (HP:0040281). (ORPHA:2211)
- Preaxial hand polydactyly (HP:0001177): Supernumerary digits located at the radial side of the hand. Polydactyly (supernumerary digits) involving the thumb occurs in many distinct forms of high variability and severity. Ranging from fleshy nubbins over varying degrees of partial duplication/splitting to completely duplicated or even triplicated thumbs or preaxial (on the radial side of the hand) supernumerary digits. Evidence: TAS. Frequency: Very frequent (HP:0040281). (ORPHA:2211)
- Flat occiput (HP:0005469): Reduced convexity of the occiput (posterior part of skull). Evidence: TAS. Frequency: Very frequent (HP:0040281). (ORPHA:2211)
- Finger syndactyly (HP:0006101): Webbing or fusion of the fingers, involving soft parts only or including bone structure. Bony fusions are referred to as "bony" Syndactyly if the fusion occurs in a radio-ulnar axis. Fusions of bones of the fingers in a proximo-distal axis are referred to as "Symphalangism". Evidence: TAS. Frequency: Very frequent (HP:0040281). (ORPHA:2211)
- Bifid scrotum (HP:0000048): Midline indentation or cleft of the scrotum. Evidence: TAS. Frequency: Frequent (HP:0040282). (ORPHA:2211)
- Broad forehead (HP:0000337): Width of the forehead or distance between the frontotemporales is more than two standard deviations above the mean (objective); or apparently increased distance between the two sides of the forehead. Evidence: TAS. Frequency: Frequent (HP:0040282). (ORPHA:2211)
- Long philtrum (HP:0000343): Distance between nasal base and midline upper lip vermilion border more than 2 SD above the mean. Alternatively, an apparently increased distance between nasal base and midline upper lip vermilion border. Evidence: TAS. Frequency: Frequent (HP:0040282). (ORPHA:2211)
- Downslanted palpebral fissures (HP:0000494): The palpebral fissure inclination is more than two standard deviations below the mean. Evidence: TAS. Frequency: Frequent (HP:0040282). (ORPHA:2211)
- Glaucoma (HP:0000501): Glaucoma refers loss of retinal ganglion cells in a characteristic pattern of optic neuropathy usually associated with increased intraocular pressure. Evidence: TAS. Frequency: Frequent (HP:0040282). (ORPHA:2211)
- Ptosis (HP:0000508): The upper eyelid margin is positioned 3 mm or more lower than usual and covers the superior portion of the iris (objective); or, the upper lid margin obscures at least part of the pupil (subjective). Evidence: TAS. Frequency: Frequent (HP:0040282). (ORPHA:2211)
- Proptosis (HP:0000520): An eye that is protruding anterior to the plane of the face to a greater extent than is typical. Evidence: TAS. Frequency: Frequent (HP:0040282). (ORPHA:2211)
- Eyelid coloboma (HP:0000625): A short discontinuity of the margin of the lower or upper eyelid. Evidence: TAS. Frequency: Frequent (HP:0040282). (ORPHA:2211)
- Broad hallux phalanx (HP:0010059): An increase in width in one or more phalanges of the big toe. Evidence: TAS. Frequency: Frequent (HP:0040282). (ORPHA:2211)
- Broad thumb (HP:0011304): Increased thumb width without increased dorso-ventral dimension. Evidence: TAS. Frequency: Frequent (HP:0040282). (ORPHA:2211)
- Sacral dimple (HP:0000960): A cutaneous indentation resulting from tethering of the skin to underlying structures (bone) of the intergluteal cleft. Evidence: TAS. Frequency: Occasional (HP:0040283). (ORPHA:2211)
- Pachygyria (HP:0001302): Pachygyria is a malformation of cortical development with abnormally wide gyri with sulci 1,5-3 cm apart and abnormally thick cortex measuring more than 5 mm (radiological definition). See also neuropathological definitions for 2-, 3-, and 4-layered lissencephaly. Evidence: TAS. Frequency: Occasional (HP:0040283). (ORPHA:2211)
- Lissencephaly (HP:0001339): A spectrum of malformations of cortical development caused by insufficient neuronal migration that subsumes the terms agyria, pachygyria and subcortical band heterotopia. See also neuropathological definitions for 2-, 3-, and 4-layered lissencephaly. Evidence: TAS. Frequency: Occasional (HP:0040283). (ORPHA:2211)
- Encephalocele (HP:0002084): A neural tube defect characterized by sac-like protrusions of the brain and the membranes that cover it through openings in the skull. Evidence: TAS. Frequency: Occasional (HP:0040283). (ORPHA:2211)
- Polymicrogyria (HP:0002126): Polymicrogyria is a congenital malformation of the cerebral cortex characterized by abnormal cortical layering (lamination) and an excessive number of small gyri (folds). Evidence: TAS. Frequency: Occasional (HP:0040283). (ORPHA:2211)
- Abnormality of neuronal migration (HP:0002269): An abnormality resulting from an anomaly of neuronal migration, i.e., of the process by which neurons travel from their origin to their final position in the brain. Evidence: TAS. Frequency: Occasional (HP:0040283). (ORPHA:2211)
- Abnormal cortical gyration (HP:0002536): An abnormality of the gyri (i.e., the ridges) of the cerebral cortex of the brain. Evidence: TAS. Frequency: Occasional (HP:0040283). (ORPHA:2211)
- Abnormal toenail morphology (HP:0008388): An anomaly of the toenail. Evidence: TAS. Frequency: Occasional (HP:0040283). (ORPHA:2211)
- Exencephaly (HP:0030769): A malformation of the neural tube with a large amount of protruding brain tissue and absence of calvarium. Evidence: TAS. Frequency: Occasional (HP:0040283). (ORPHA:2211)